- Hyperpigmentation of the skin (HP:0000953): A darkening of the skin related to an increase in melanin production and deposition. Evidence: TAS. (OMIM:161530)
- Autosomal dominant inheritance (HP:0000006): A mode of inheritance that is observed for traits related to a gene encoded on one of the autosomes (i.e., the human chromosomes 1-22) in which a trait manifests in heterozygotes. In the context of medical genetics, an autosomal dominant disorder is caused when a single copy of the mutant allele is present. Males and females are affected equally, and can both transmit the disorder with a risk of 50% for each child of inheriting the mutant allele. Evidence: IEA. (OMIM:161530)
These phenotypes are associated with the disease nasal hyperpigmentation, familial transverse (OMIM:161530).